Phenotypes associated with the disease intellectual disability, autosomal dominant 4 (OMIM:612581):
- Short chin (HP:0000331): Decreased vertical distance from the vermilion border of the lower lip to the inferior-most point of the chin. Evidence: IEA. (OMIM:612581)
- Midface retrusion (HP:0011800): Posterior positions and/or vertical shortening of the infraorbital and perialar regions, or increased concavity of the face and/or reduced nasolabial angle. Evidence: IEA. (OMIM:612581)
- Syndactyly (HP:0001159): Webbing or fusion of the fingers or toes, involving soft parts only or including bone structure. Bony fusions are referred to as "bony" syndactyly if the fusion occurs in a radio-ulnar axis. Fusions of bones of the fingers or toes in a proximo-distal axis are referred to as "symphalangism". Evidence: IEA. (OMIM:612581)
- Autosomal dominant inheritance (HP:0000006): A mode of inheritance that is observed for traits related to a gene encoded on one of the autosomes (i.e., the human chromosomes 1-22) in which a trait manifests in heterozygotes. In the context of medical genetics, an autosomal dominant disorder is caused when a single copy of the mutant allele is present. Males and females are affected equally, and can both transmit the disorder with a risk of 50% for each child of inheriting the mutant allele. Evidence: TAS. (PMID:19012874)
- Intellectual disability (HP:0001249): The term intellectual disability or intellectual developmental disorder is used to describe significantly sub-average intellectual and adaptive functioning based on clinical assessment and as measured by individually administered, appropriately normed, standardized and validated tests of intellectual functioning and adaptive behavior, with onset during the developmental period from infancy through adolescence. Evidence: TAS. (PMID:19012874)
- Short toe (HP:0001831): A toe that appears disproportionately short compared to the foot. Evidence: IEA. (OMIM:612581)
- Exotropia (HP:0000577): A form of strabismus with one or both eyes deviated outward. Evidence: IEA. (OMIM:612581)
- Severe intellectual disability (HP:0010864): Severe intellectual disability (ID) is defined as a type of ID characterized by severely sub-average adaptive functioning and intellectual functioning, with an intelligence quotient (IQ) the range of 20-34. Evidence: IEA. (OMIM:612581)